- Abnormal vestibular function (HP:0001751): An abnormality of the functioning of the vestibular apparatus. Evidence: PCS. Frequency: 0/3. (PMID:12471561)
- Sensorineural hearing impairment (HP:0000407): A type of hearing impairment in one or both ears related to an abnormal functionality of the cochlear nerve. Evidence: PCS. Frequency: 3/3. (PMID:12471561)
- Childhood onset (HP:0011463): Onset of disease at the age of between 1 and 5 years. Evidence: PCS. Frequency: 3/3. (PMID:12471561)
- Autosomal dominant inheritance (HP:0000006): A mode of inheritance that is observed for traits related to a gene encoded on one of the autosomes (i.e., the human chromosomes 1-22) in which a trait manifests in heterozygotes. In the context of medical genetics, an autosomal dominant disorder is caused when a single copy of the mutant allele is present. Males and females are affected equally, and can both transmit the disorder with a risk of 50% for each child of inheriting the mutant allele. Evidence: PCS. (PMID:12471561)
- Intellectual disability (HP:0001249): The term intellectual disability or intellectual developmental disorder is used to describe significantly sub-average intellectual and adaptive functioning based on clinical assessment and as measured by individually administered, appropriately normed, standardized and validated tests of intellectual functioning and adaptive behavior, with onset during the developmental period from infancy through adolescence. Evidence: PCS. Frequency: 0/3. (PMID:12471561)
These phenotypes are associated with the disease autosomal dominant nonsyndromic hearing loss 40 (OMIM:616357).